Phenotypes associated with the disease congenital myasthenic syndrome 17 (OMIM:616304):
- Hyporeflexia (HP:0001265): Reduction of neurologic reflexes such as the knee-jerk reaction. Evidence: PCS. Frequency: 1/1. (PMID:24234652)
- Congenital onset (HP:0003577): A phenotypic abnormality that is present at birth. Evidence: PCS. Frequency: 1/1. (PMID:24234652)
- Gait disturbance (HP:0001288): The term gait disturbance can refer to any disruption of the ability to walk. Evidence: PCS. Frequency: 1/1. (PMID:24234652)
- Feeding difficulties (HP:0011968): Impaired ability to eat related to problems gathering food and getting ready to suck, chew, or swallow it. Evidence: PCS. Frequency: 1/1. (PMID:24234652)
- Ptosis (HP:0000508): The upper eyelid margin is positioned 3 mm or more lower than usual and covers the superior portion of the iris (objective); or, the upper lid margin obscures at least part of the pupil (subjective). Evidence: PCS. Frequency: 1/1. (PMID:24234652)
- Autosomal recessive inheritance (HP:0000007): A mode of inheritance that is observed for traits related to a gene encoded on one of the autosomes (i.e., the human chromosomes 1-22) in which a trait manifests in individuals with two pathogenic alleles, either homozygotes (two copies of the same mutant allele) or compound heterozygotes (whereby each copy of a gene has a distinct mutant allele). Evidence: PCS. (PMID:24234652)
- Type 1 muscle fiber predominance (HP:0003803): An abnormal predominance of type I muscle fibers (in general, this feature can only be observed on muscle biopsy). Evidence: PCS. Frequency: 1/1. (PMID:24234652)
- Muscle weakness (HP:0001324): Reduced strength of muscles. Evidence: PCS. Frequency: 1/1. (PMID:24234652)
- EMG: decremental response of compound muscle action potential to repetitive nerve stimulation (HP:0003403): A compound muscle action potential (CMAP) is a type of electromyography (EMG). CMAP refers to a group of almost simultaneous action potentials from several muscle fibers in the same area evoked by stimulation of the supplying motor nerve and are recorded as one multipeaked summated action potential. This abnormality refers to a greater than normal decrease in the amplitude during the course of the investigation. Evidence: PCS. Frequency: 1/1. (PMID:24234652)